- Abnormality of the nervous system (HP:0000707): An abnormality of the nervous system. Evidence: IEA. (OMIM:309840)
- X-linked inheritance (HP:0001417): A mode of inheritance that is observed for traits related to a gene encoded on the X chromosome. Evidence: IEA. (OMIM:309840)
These phenotypes are associated with the disease modifier, X-linked, for Neurofunctional defects (OMIM:309840).